- Stage 5 chronic kidney disease (HP:0003774): A degree of kidney failure severe enough to require dialysis or kidney transplantation for survival characterized by a severe reduction in glomerular filtration rate (less than 15 ml/min/1.73 m2) and other manifestations including increased serum creatinine. Evidence: PCS. Frequency: 3/6. Onset: Young adult onset (HP:0011462). (PMID:32827185)
- Spicular pigmentation of the retina (HP:0007737): Pigment migration into the retina in a bone-spicule configuration (resembling the nucleated cells within the lacuna of bone). Evidence: PCS. Frequency: 1/6. (PMID:32827185)
- Bilateral sensorineural hearing impairment (HP:0008619): A form of sensorineural hearing impairment that affects both ears. Evidence: PCS. Frequency: 1/6. (PMID:32827185)
- Delayed speech and language development (HP:0000750): A degree of language development that is significantly below the norm for a child of a specified age. Evidence: PCS. Frequency: 1/6. (PMID:32827185)
- Hearing impairment (HP:0000365): A decreased magnitude of the sensory perception of sound. Evidence: PCS. Frequency: 4/6. (PMID:32827185)
- Short stature (HP:0004322): A height below that which is expected according to age and gender norms. Although there is no universally accepted definition of short stature, many refer to "short stature" as height more than 2 standard deviations below the mean for age and gender (or below the 3rd percentile for age and gender dependent norms). Evidence: PCS. Frequency: 1/6. (PMID:32827185)
- Glycosuria (HP:0003076): An increased concentration of glucose in the urine. Evidence: PCS. Frequency: 1/6. (PMID:32827185)
- Cataract (HP:0000518): A cataract is an opacity or clouding that develops in the crystalline lens of the eye or in its capsule. Evidence: PCS. Frequency: 1/6. (PMID:32827185)
- Childhood onset (HP:0011463): Onset of disease at the age of between 1 and 5 years. Evidence: PCS. Frequency: 6/6. (PMID:32827185)
- Sensorineural hearing impairment (HP:0000407): A type of hearing impairment in one or both ears related to an abnormal functionality of the cochlear nerve. Evidence: PCS. Frequency: 1/6. (PMID:32827185)
- Rickets (HP:0002748): Rickets is divided into two major categories including calcipenic and phosphopenic. Hypophosphatemia is described as a common manifestation of both categories. Hypophosphatemic rickets is the most common type of rickets that is characterized by low levels of serum phosphate, resistance to ultraviolet radiation or vitamin D intake. There are several issues involved in hypophosphatemic rickets such as calcium, vitamin D, phosphorus deficiencies. Moreover, other disorder can be associated with its occurrence such as absorption defects due to pancreatic, intestinal, gastric, and renal disorders and hepatobiliary disease. Symptoms are usually seen in childhood and can be varied in severity. Severe forms may be linked to bowing of the legs, poor bone growth, and short stature as well as joint and bone pain. Hypophosphatemic rickets are associated with renal excretion of phosphate, hypophosphatemia, and mineral defects in bones. The familial type of the disease is the most common type of rickets. Evidence: PCS. Frequency: 4/6. (PMID:32827185)
- Autosomal recessive inheritance (HP:0000007): A mode of inheritance that is observed for traits related to a gene encoded on one of the autosomes (i.e., the human chromosomes 1-22) in which a trait manifests in individuals with two pathogenic alleles, either homozygotes (two copies of the same mutant allele) or compound heterozygotes (whereby each copy of a gene has a distinct mutant allele). Evidence: PCS. (PMID:32827185)
- Optic atrophy (HP:0000648): Atrophy of the optic nerve. Optic atrophy results from the death of the retinal ganglion cell axons that comprise the optic nerve and manifesting as a pale optic nerve on fundoscopy. Evidence: PCS. Frequency: 1/6. (PMID:32827185)
- Peripheral visual field loss (HP:0007994): Loss of peripheral vision with retention of central vision, resulting in a constricted circular tunnel-like field of vision. Evidence: PCS. Frequency: 1/6. (PMID:32827185)
- Visual impairment (HP:0000505): Visual impairment (or vision impairment) is vision loss (of a person) to such a degree as to qualify as an additional support need through a significant limitation of visual capability resulting from either disease, trauma, or congenital or degenerative conditions that cannot be corrected by conventional means, such as refractive correction, medication, or surgery. Evidence: PCS. Frequency: 6/6. (PMID:32827185)
- Recurrent fractures (HP:0002757): The repeated occurrence of bone fractures (implying an abnormally increased tendency for fracture). Evidence: PCS. Frequency: 1/6. (PMID:32827185)
- Optic disc pallor (HP:0000543): A pale yellow discoloration of the optic disc (the area of the optic nerve head in the retina). The optic disc normally has a pinkish hue with a central yellowish depression. Evidence: PCS. Frequency: 1/6. (PMID:32827185)
- Rod-cone dystrophy (HP:0000510): An inherited retinal disease subtype in which the rod photoreceptors appear to be more severely affected than the cone photoreceptors. Typical presentation is with nyctalopia (due to rod dysfunction) followed by loss of mid-peripheral field of vision, which gradually extends and leaves many patients with a small central island of vision due to the preservation of macular cones. Evidence: PCS. Frequency: 6/6. (PMID:32827185)
- Renal Fanconi syndrome (HP:0001994): An inability of the tubules in the kidney to reabsorb small molecules, causing increased urinary loss of electrolytes (sodium, potassium, bicarbonate), minerals, glucose, amino acids, and water. Evidence: PCS. Frequency: 6/6. (PMID:32827185)
These phenotypes are associated with the disease rod-cone dystrophy, sensorineural deafness, and Fanconi-type renal dysfunction (OMIM:268315).